Phenotypes associated with the disease Schaaf-Yang syndrome (ORPHA:398069):
- Cryptorchidism (HP:0000028): Testis in inguinal canal. That is, absence of one or both testes from the scrotum owing to failure of the testis or testes to descend through the inguinal canal to the scrotum. Evidence: TAS. Frequency: Very frequent (HP:0040281). (ORPHA:398069)
- Infertility (HP:0000789). Evidence: TAS. Frequency: Very frequent (HP:0040281). (ORPHA:398069)
- Intellectual disability (HP:0001249): The term intellectual disability or intellectual developmental disorder is used to describe significantly sub-average intellectual and adaptive functioning based on clinical assessment and as measured by individually administered, appropriately normed, standardized and validated tests of intellectual functioning and adaptive behavior, with onset during the developmental period from infancy through adolescence. Evidence: TAS. Frequency: Very frequent (HP:0040281). (ORPHA:398069)
- Motor delay (HP:0001270): A type of Developmental delay characterized by a delay in acquiring motor skills. Evidence: TAS. Frequency: Very frequent (HP:0040281). (ORPHA:398069)
- Neonatal hypotonia (HP:0001319): Muscular hypotonia (abnormally low muscle tone) manifesting in the neonatal period. Evidence: TAS. Frequency: Very frequent (HP:0040281). (ORPHA:398069)
- Flexion contracture (HP:0001371): A flexion contracture is a bent (flexed) joint that cannot be straightened actively or passively. It is thus a chronic loss of joint motion due to structural changes in muscle, tendons, ligaments, or skin that prevents normal movement of joints. Evidence: TAS. Frequency: Very frequent (HP:0040281). (ORPHA:398069)
- Abnormal facial shape (HP:0001999): An abnormal morphology (form) of the face or its components. Evidence: TAS. Frequency: Very frequent (HP:0040281). (ORPHA:398069)
- Poor suck (HP:0002033): An inadequate sucking reflex, resulting in the difficult of newborns to be breast-fed. Evidence: TAS. Frequency: Very frequent (HP:0040281). (ORPHA:398069)
- Floppy infant (HP:0008947): Floppiness/hypotonia is defined as reduced resistance to passive movement of joints. Physical examination of floppy/hypotonic infants shows head lag, lack of shoulder and elbow muscle contraction on traction response, inability to tighten the shoulder girdle muscles (or slipping through) when held under the axillae, scarf sign (when the arm is pulled to the opposite side, the arm wraps around the neck with the elbow crossing midline), hyperdorsiflexion of the feet, easy apposition of the thumb against the forearm, feet touching the cheek with ease and without discomfort, frog leg position, and inverted U sign on ventral suspension (head, arms, and legs hanging down without elbow or knee flexion and the trunk rounded in a dome shape). Evidence: TAS. Frequency: Very frequent (HP:0040281). (ORPHA:398069)
- Feeding difficulties (HP:0011968): Impaired ability to eat related to problems gathering food and getting ready to suck, chew, or swallow it. Evidence: TAS. Frequency: Very frequent (HP:0040281). (ORPHA:398069)
- Neurodevelopmental delay (HP:0012758): Neurodevelopmental delay (NDD) refers to delays in the maturation of the brain and central nervous system; infants and young children with NDD may experience delays in the development of one or more skills including gross motor abilities, fine-motor coordination, language abilities and ability to solve increasingly complex problems. Evidence: TAS. Frequency: Very frequent (HP:0040281). (ORPHA:398069)
- Small scrotum (HP:0000046): Apparently small scrotum for age. Evidence: TAS. Frequency: Frequent (HP:0040282). (ORPHA:398069)
- Clitoral hypoplasia (HP:0000060): Developmental hypoplasia of the clitoris. Evidence: TAS. Frequency: Frequent (HP:0040282). (ORPHA:398069)
- Hypoplastic labia minora (HP:0000064). Evidence: TAS. Frequency: Frequent (HP:0040282). (ORPHA:398069)
- Hypogonadism (HP:0000135): A decreased functionality of the gonad. Evidence: TAS. Frequency: Frequent (HP:0040282). (ORPHA:398069)
- Abnormality of the eye (HP:0000478): Any abnormality of the eye, including location, spacing, and intraocular abnormalities. Evidence: TAS. Frequency: Frequent (HP:0040282). (ORPHA:398069)
- Strabismus (HP:0000486): A misalignment of the eyes so that the visual axes deviate from bifoveal fixation. The classification of strabismus may be based on a number of features including the relative position of the eyes, whether the deviation is latent or manifest, intermittent or constant, concomitant or otherwise and according to the age of onset and the relevance of any associated refractive error. Evidence: TAS. Frequency: Frequent (HP:0040282). (ORPHA:398069)
- Atypical behavior (HP:0000708): Atypical behavior is an abnormality in a person's actions that can be controlled or modulated by the will of the individual. While abnormal behaviors can be difficult to control, they are distinct from other abnormal actions that cannot be affected by the individual's will. Evidence: TAS. Frequency: Frequent (HP:0040282). (ORPHA:398069)
- Autistic behavior (HP:0000729): Persistent deficits in social interaction and communication and interaction as well as a markedly restricted repertoire of activity and interest as well as repetitive patterns of behavior. Evidence: TAS. Frequency: Frequent (HP:0040282). (ORPHA:398069)
- Delayed speech and language development (HP:0000750): A degree of language development that is significantly below the norm for a child of a specified age. Evidence: TAS. Frequency: Frequent (HP:0040282). (ORPHA:398069)
- Primary amenorrhea (HP:0000786). Evidence: TAS. Frequency: Frequent (HP:0040282). (ORPHA:398069)
- Mild intellectual disability (HP:0001256): Mild intellectual disability (ID) is defined as a type of ID characterized by mildly sub-average adaptive functioning and intellectual functioning, with an intelligence quotient (IQ) the range of 50-69. Evidence: TAS. Frequency: Frequent (HP:0040282). (ORPHA:398069)
- Diminished deep tendon reflex (HP:0001315): A reduction (hyporeflexia) or complete absence (areflexia) of the involuntary muscle contraction normally elicited by a reflex stimulus, such as tapping a deep tendon. Evidence: TAS. Frequency: Frequent (HP:0040282). (ORPHA:398069)
- Specific learning disability (HP:0001328): Impairment of certain skills such as reading or writing, coordination, self-control, or attention that interfere with the ability to learn. The impairment is not related to a global deficiency of intelligence. Evidence: TAS. Frequency: Frequent (HP:0040282). (ORPHA:398069)
- Failure to thrive (HP:0001508): Failure to thrive (FTT) refers to a child whose physical growth is substantially below the norm. Evidence: TAS. Frequency: Frequent (HP:0040282). (ORPHA:398069)
- Decreased fetal movement (HP:0001558): An abnormal reduction in quantity or strength of fetal movements. Evidence: TAS. Frequency: Frequent (HP:0040282). (ORPHA:398069)
- Weak cry (HP:0001612). Evidence: TAS. Frequency: Frequent (HP:0040282). (ORPHA:398069)
- Short foot (HP:0001773): A measured foot length that is more than 2 SD below the mean for a newborn of 27 - 41 weeks gestation, or foot that is less than the 3rd centile for individuals from birth to 16 years of age (objective). Alternatively, a foot that appears disproportionately short (subjective). Evidence: TAS. Frequency: Frequent (HP:0040282). (ORPHA:398069)
- Gastroesophageal reflux (HP:0002020): A condition in which the stomach contents leak backwards from the stomach into the esophagus through the lower esophageal sphincter. Evidence: TAS. Frequency: Frequent (HP:0040282). (ORPHA:398069)
- Ventriculomegaly (HP:0002119): An increase in size of the ventricular system of the brain. Evidence: TAS. Frequency: Frequent (HP:0040282). (ORPHA:398069)
- Polyphagia (HP:0002591): A neurological anomaly with gross overeating associated with an abnormally strong desire or need to eat. Evidence: TAS. Frequency: Frequent (HP:0040282). (ORPHA:398069)
- Scoliosis (HP:0002650): The presence of an abnormal lateral curvature of the spine. Evidence: TAS. Frequency: Frequent (HP:0040282). (ORPHA:398069)
- Kyphosis (HP:0002808): Exaggerated anterior convexity of the thoracic vertebral column. Evidence: TAS. Frequency: Frequent (HP:0040282). (ORPHA:398069)
- External genital hypoplasia (HP:0003241): Underdevelopment of part or all of the external reproductive organs. Evidence: TAS. Frequency: Frequent (HP:0040282). (ORPHA:398069)
- Short stature (HP:0004322): A height below that which is expected according to age and gender norms. Although there is no universally accepted definition of short stature, many refer to "short stature" as height more than 2 standard deviations below the mean for age and gender (or below the 3rd percentile for age and gender dependent norms). Evidence: TAS. Frequency: Frequent (HP:0040282). (ORPHA:398069)
- Increased body weight (HP:0004324): Abnormally increased body weight. Evidence: TAS. Frequency: Frequent (HP:0040282). (ORPHA:398069)
- Temperature instability (HP:0005968): Disordered thermoregulation characterized by an impaired ability to maintain a balance between heat production and heat loss, with resulting instability of body temperature. Evidence: TAS. Frequency: Frequent (HP:0040282). (ORPHA:398069)
- Borderline intellectual disability (HP:0006889): Borderline intellectual disability is defined as an intelligence quotient (IQ) in the range of 70-85. Evidence: TAS. Frequency: Frequent (HP:0040282). (ORPHA:398069)
- Absence of pubertal development (HP:0008197). Evidence: TAS. Frequency: Frequent (HP:0040282). (ORPHA:398069)
- Decreased testicular size (HP:0008734): Reduced volume of the testicle (the male gonad). Evidence: TAS. Frequency: Frequent (HP:0040282). (ORPHA:398069)
- Sleep apnea (HP:0010535): An intermittent cessation of airflow at the mouth and nose during sleep is known as sleep apnea. Apneas that last at least 10 seconds are considered significant, but individuals with sleep apnea may experience apneas lasting from 20 seconds up to 2 or 3 minutes. Patients may have up to 15 events per hour of sleep. Evidence: TAS. Frequency: Frequent (HP:0040282). (ORPHA:398069)
- Skin-picking (HP:0012166): Repetitive and compulsive picking of skin which results in tissue damage. Evidence: TAS. Frequency: Frequent (HP:0040282). (ORPHA:398069)
- Hypothalamic luteinizing hormone-releasing hormone deficiency (HP:0012287): Decreased secretion of luteinizing hormone-releasing hormone by the hypothalamus. Evidence: TAS. Frequency: Frequent (HP:0040282). (ORPHA:398069)
- Chronic constipation (HP:0012450): Constipation for longer than three months with fewer than 3 bowel movements per week, straining, lumpy or hard stools, and a sensation of anorectal obstruction or incomplete defecation. Evidence: TAS. Frequency: Frequent (HP:0040282). (ORPHA:398069)
- Small pituitary gland (HP:0012506): An abnormally decreased size of the pituitary gland. Evidence: TAS. Frequency: Frequent (HP:0040282). (ORPHA:398069)
- Abdominal obesity (HP:0012743): Excessive fat around the stomach and abdomen. Evidence: TAS. Frequency: Frequent (HP:0040282). (ORPHA:398069)
- Abnormal temper tantrums (HP:0025160): Temper tantrums are brief episodes of extreme, unpleasant, and sometimes aggressive behaviors in response to frustration or anger, which are a normal part of development in toddlers. Temper tantrums that occur more frequently in a given time and/or are more severe in symptomatology and/or longer in duration and/or inappropriate for the given age compared to a temper tantrum that naturally occurs as a part of the developmental process are classified as abnormal temper tantrums. Evidence: TAS. Frequency: Frequent (HP:0040282). (ORPHA:398069)
- Nasogastric tube feeding (HP:0040288): The condition of inability to eat normally treated by placement of a thin tube through the nose into the stomach that is then used to carry food. Evidence: TAS. Frequency: Frequent (HP:0040282). (ORPHA:398069)
- Cognitive impairment (HP:0100543): Abnormal cognition is characterized by deficits in thinking, reasoning, or remembering. Evidence: TAS. Frequency: Frequent (HP:0040282). (ORPHA:398069)
- Small hand (HP:0200055): Disproportionately small hand. Evidence: TAS. Frequency: Frequent (HP:0040282). (ORPHA:398069)
- Brain imaging abnormality (HP:0410263): An anomaly of metabolism or structure of the brain identified by imaging. Evidence: TAS. Frequency: Frequent (HP:0040282). (ORPHA:398069)
- Micropenis (HP:0000054): Abnormally small penis. At birth, the normal penis is about 3 cm (stretched length from pubic tubercle to tip of penis) with micropenis less than 2.0-2.5 cm. Evidence: TAS. Frequency: Occasional (HP:0040283). (ORPHA:398069)
- Xerostomia (HP:0000217): Dryness of the mouth due to salivary gland dysfunction. Evidence: TAS. Frequency: Occasional (HP:0040283). (ORPHA:398069)
- Thin upper lip vermilion (HP:0000219): Height of the vermilion of the upper lip in the midline more than 2 SD below the mean. Alternatively, an apparently reduced height of the vermilion of the upper lip in the frontal view (subjective). Evidence: TAS. Frequency: Occasional (HP:0040283). (ORPHA:398069)
- Narrow nasal bridge (HP:0000446): Decreased width of the bony bridge of the nose. Evidence: TAS. Frequency: Occasional (HP:0040283). (ORPHA:398069)
- Myopia (HP:0000545): An abnormality of refraction characterized by the ability to see objects nearby clearly, while objects in the distance appear blurry. Evidence: TAS. Frequency: Occasional (HP:0040283). (ORPHA:398069)
- Esotropia (HP:0000565): A form of strabismus with one or both eyes turned inward ('crossed') to a relatively severe degree, usually defined as 10 diopters or more. Evidence: TAS. Frequency: Occasional (HP:0040283). (ORPHA:398069)
- Psychosis (HP:0000709): A condition characterized by changes in personality and thought patterns, often accompanied by hallucinations and delusional beliefs, is known as psychosis. Evidence: TAS. Frequency: Occasional (HP:0040283). (ORPHA:398069)
- Compulsive behaviors (HP:0000722): Behavior that consists of repetitive acts, characterized by the feeling that one "has to" perform them, while being aware that these acts are not in line with one's overall goal. Evidence: TAS. Frequency: Occasional (HP:0040283). (ORPHA:398069)
- Precocious puberty (HP:0000826): The onset of secondary sexual characteristics before a normal age. Although it is difficult to define normal age ranges because of the marked variation with which puberty begins in normal children, precocious puberty can be defined as the onset of puberty before the age of 8 years in girls or 9 years in boys. Evidence: TAS. Frequency: Occasional (HP:0040283). (ORPHA:398069)
- Osteopenia (HP:0000938): Osteopenia is a term to define bone density that is not normal but also not as low as osteoporosis. By definition from the World Health Organization osteopenia is defined by bone densitometry as a T score -1 to -2.5. Evidence: TAS. Frequency: Occasional (HP:0040283). (ORPHA:398069)
- Osteoporosis (HP:0000939): Osteoporosis is a systemic skeletal disease characterized by low bone density and microarchitectural deterioration of bone tissue with a consequent increase in bone fragility. According to the WHO criteria, osteoporosis is defined as a BMD that lies 2.5 standard deviations or more below the average value for young healthy adults (a T-score below -2.5 SD). Evidence: TAS. Frequency: Occasional (HP:0040283). (ORPHA:398069)
- Hypopigmentation of the skin (HP:0001010): A reduction of skin color related to a decrease in melanin production and deposition. Evidence: TAS. Frequency: Occasional (HP:0040283). (ORPHA:398069)
- Seizure (HP:0001250): A seizure is an intermittent abnormality of nervous system physiology characterized by a transient occurrence of signs and/or symptoms due to abnormal excessive or synchronous neuronal activity in the brain. Evidence: TAS. Frequency: Occasional (HP:0040283). (ORPHA:398069)
- Lethargy (HP:0001254): A state of fatigue, either physical or mental slowness and sluggishness, with difficulties in initiating or performing simple tasks. Distinguished from apathy which implies indifference and a lack of desire or interest in the task. A person with lethargy may have the desire, but not the energy to engage in personal or socially relevant tasks. Evidence: TAS. Frequency: Occasional (HP:0040283). (ORPHA:398069)
- Hip dysplasia (HP:0001385): The presence of developmental dysplasia of the hip. Evidence: TAS. Frequency: Occasional (HP:0040283). (ORPHA:398069)
- Atrial septal defect (HP:0001631): Atrial septal defect (ASD) is a congenital abnormality of the interatrial septum that enables blood flow between the left and right atria via the interatrial septum. Evidence: TAS. Frequency: Occasional (HP:0040283). (ORPHA:398069)
- Recurrent respiratory infections (HP:0002205): An increased susceptibility to respiratory infections as manifested by a history of recurrent respiratory infections. Evidence: TAS. Frequency: Occasional (HP:0040283). (ORPHA:398069)
- Abnormal rapid eye movement sleep (HP:0002494): Abnormality of REM Sleep are phases of REM sleep are characterized by desynchronized EEG patterns, increases in heart rate and blood pressure, sympathetic activation, and a profound loss of muscle tone except for the eye and middle-ear muscles. There are also phases of rapid eye movements. Evidence: TAS. Frequency: Occasional (HP:0040283). (ORPHA:398069)
- Downturned corners of mouth (HP:0002714): A morphological abnormality of the mouth in which the angle of the mouth is downturned. The oral commissures are positioned inferior to the midline labial fissure. Evidence: TAS. Frequency: Occasional (HP:0040283). (ORPHA:398069)
- Obstructive sleep apnea (HP:0002870): Obstructive Sleep Apnea is a condition characterized by the obstruction of the airway and pauses in breathing during sleep, which occur multiple times throughout the night. It is related to the relaxation of muscle tone that typically happens during sleep, leading to a partial collapse of the soft tissues in the airway and causing airflow obstruction. Evidence: TAS. Frequency: Occasional (HP:0040283). (ORPHA:398069)
- Hypopigmentation of hair (HP:0005599). Evidence: TAS. Frequency: Occasional (HP:0040283). (ORPHA:398069)
- Type II diabetes mellitus (HP:0005978): A type of diabetes mellitus initially characterized by insulin resistance and hyperinsulinemia and subsequently by glucose interolerance and hyperglycemia. Evidence: TAS. Frequency: Occasional (HP:0040283). (ORPHA:398069)
- Almond-shaped palpebral fissure (HP:0007874): A shape created by an acute downward arching of the upper eyelid and upward arching of the lower eyelid, toward the medial canthus, which gives the outline of the palpebral fissures the configuration of an almond. Thus, the maximum distance between the fissures is offset from, and medial to, the center point. Evidence: TAS. Frequency: Occasional (HP:0040283). (ORPHA:398069)
- Central sleep apnea (HP:0010536): Sleep apnea results from a temporary loss of the central drive to the muscles responsible for breathing. Evidence: TAS. Frequency: Occasional (HP:0040283). (ORPHA:398069)
- Impaired temperature sensation (HP:0010829): A reduced ability to discriminate between different temperatures. Evidence: TAS. Frequency: Occasional (HP:0040283). (ORPHA:398069)
- Central hypothyroidism (HP:0011787): A type of hypothyroidism due to an insufficient stimulation of an otherwise normal thyroid gland. Central hypothyroidism is caused by either pituitary (secondary hypothyroidism) or hypothalamic (tertiary hypothyroidism) defects. Evidence: TAS. Frequency: Occasional (HP:0040283). (ORPHA:398069)
- Premature pubarche (HP:0012411): The onset of growth of pubic hair at an earlier age than normal. Evidence: TAS. Frequency: Occasional (HP:0040283). (ORPHA:398069)
- Chorioretinal hypopigmentation (HP:0040030): Focal or global or heterogeneous loss of choroidal and retinal pigment epithelium (RPE) pigmentation in the absence of atrophy. Evidence: TAS. Frequency: Occasional (HP:0040283). (ORPHA:398069)
- Impulsivity (HP:0100710): Acting on the spur of the moment or on a momentary basis without consideration of outcomes; having difficulty establishing or following plans; experiencing a sense of urgency and engaging in behavior that is uninhibited, cannot be inhibited, and is uncontrolled. The possibility of repression is inconceivable. Evidence: TAS. Frequency: Occasional (HP:0040283). (ORPHA:398069)